- Abnormality of the skeletal system (HP:0000924): An abnormality of the skeletal system. Evidence: IEA. (OMIM:179600)
- Raynaud phenomenon (HP:0030880). Evidence: TAS. (OMIM:179600)
- Autosomal dominant inheritance (HP:0000006): A mode of inheritance that is observed for traits related to a gene encoded on one of the autosomes (i.e., the human chromosomes 1-22) in which a trait manifests in heterozygotes. In the context of medical genetics, an autosomal dominant disorder is caused when a single copy of the mutant allele is present. Males and females are affected equally, and can both transmit the disorder with a risk of 50% for each child of inheriting the mutant allele. Evidence: IEA. (OMIM:179600)
These phenotypes are associated with the disease Raynaud disease (OMIM:179600).